- Type A brachydactyly (HP:0009370). Evidence: TAS. (OMIM:607004)
- Short stature (HP:0004322): A height below that which is expected according to age and gender norms. Although there is no universally accepted definition of short stature, many refer to "short stature" as height more than 2 standard deviations below the mean for age and gender (or below the 3rd percentile for age and gender dependent norms). Evidence: IEA. (OMIM:607004)
- Cone-shaped epiphyses of the phalanges of the hand (HP:0010230): A cone-shaped appearance of the epiphyses of the fingers of the hand, producing a 'ball-in-a-socket' appearance. The related entity 'angel-shaped' epiphysis refers to a pronounced cone-shaped epiphysis in combination with a pseudoepiphysis at the distal end of a phalanx. Evidence: IEA. (OMIM:607004)
- Broad distal hallux (HP:0008111). Evidence: TAS. (OMIM:607004)
- Short distal phalanx of finger (HP:0009882): Short distance from the end of the finger to the most distal interphalangeal crease or the distal interphalangeal joint flexion point. That is, hypoplasia of one or more of the distal phalanx of finger. Evidence: IEA. (OMIM:607004)
- Short middle phalanx of finger (HP:0005819): Short (hypoplastic) middle phalanx of finger, affecting one or more fingers. Evidence: IEA. (OMIM:607004)
- Radial deviation of finger (HP:0009466): Bending or curvature of a finger toward the radial side (i.e., towards the thumb). The deviation is at the metacarpal-phalangeal joint, and this finding is distinct from clinodactyly. Evidence: IEA. (OMIM:607004)
- Short 5th metacarpal (HP:0010047): Short fifth metacarpal bone. Evidence: IEA. (OMIM:607004)
- Clinodactyly (HP:0030084): An angulation of a digit at an interphalangeal joint in the plane of the palm (finger) or sole (toe). Evidence: TAS. (OMIM:607004)
- Autosomal dominant inheritance (HP:0000006): A mode of inheritance that is observed for traits related to a gene encoded on one of the autosomes (i.e., the human chromosomes 1-22) in which a trait manifests in heterozygotes. In the context of medical genetics, an autosomal dominant disorder is caused when a single copy of the mutant allele is present. Males and females are affected equally, and can both transmit the disorder with a risk of 50% for each child of inheriting the mutant allele. Evidence: IEA. (OMIM:607004)
These phenotypes are associated with the disease brachydactyly type A1B (OMIM:607004).